Phenotypes associated with the disease Brachydactyly-short stature-retinitis pigmentosa syndrome (ORPHA:166035):
- Retinal degeneration (HP:0000546): A nonspecific term denoting progressive loss of the retinal pigment epithelium (RPE) and/or neurosensory retinal cells. Evidence: TAS. Frequency: Very frequent (HP:0040281). (ORPHA:166035)
- Abnormality of the nervous system (HP:0000707): An abnormality of the nervous system. Evidence: TAS. Frequency: Very frequent (HP:0040281). (ORPHA:166035)
- Brachydactyly (HP:0001156): Digits that appear disproportionately short compared to the hand/foot. The word brachydactyly is used here to describe a series distinct patterns of shortened digits (brachydactyly types A-E). This is the sense used here. Evidence: TAS. Frequency: Very frequent (HP:0040281). (ORPHA:166035)
- Abnormal facial shape (HP:0001999): An abnormal morphology (form) of the face or its components. Evidence: TAS. Frequency: Very frequent (HP:0040281). (ORPHA:166035)
- Short stature (HP:0004322): A height below that which is expected according to age and gender norms. Although there is no universally accepted definition of short stature, many refer to "short stature" as height more than 2 standard deviations below the mean for age and gender (or below the 3rd percentile for age and gender dependent norms). Evidence: TAS. Frequency: Very frequent (HP:0040281). (ORPHA:166035)
- Rod-cone dystrophy (HP:0000510): An inherited retinal disease subtype in which the rod photoreceptors appear to be more severely affected than the cone photoreceptors. Typical presentation is with nyctalopia (due to rod dysfunction) followed by loss of mid-peripheral field of vision, which gradually extends and leaves many patients with a small central island of vision due to the preservation of macular cones. Evidence: TAS. Frequency: Frequent (HP:0040282). (ORPHA:166035)
- Nyctalopia (HP:0000662): Inability to see well at night or in poor light. Evidence: TAS. Frequency: Frequent (HP:0040282). (ORPHA:166035)
- Delayed speech and language development (HP:0000750): A degree of language development that is significantly below the norm for a child of a specified age. Evidence: TAS. Frequency: Frequent (HP:0040282). (ORPHA:166035)
- Intellectual disability (HP:0001249): The term intellectual disability or intellectual developmental disorder is used to describe significantly sub-average intellectual and adaptive functioning based on clinical assessment and as measured by individually administered, appropriately normed, standardized and validated tests of intellectual functioning and adaptive behavior, with onset during the developmental period from infancy through adolescence. Evidence: TAS. Frequency: Frequent (HP:0040282). (ORPHA:166035)
- Global developmental delay (HP:0001263): A delay in the achievement of motor or mental milestones in the domains of development of a child, including motor skills, speech and language, cognitive skills, and social and emotional skills. This term should only be used to describe children younger than five years of age. Evidence: TAS. Frequency: Frequent (HP:0040282). (ORPHA:166035)
- Feeding difficulties (HP:0011968): Impaired ability to eat related to problems gathering food and getting ready to suck, chew, or swallow it. Evidence: TAS. Frequency: Frequent (HP:0040282). (ORPHA:166035)
- Inguinal hernia (HP:0000023): Protrusion of the contents of the abdominal cavity through the inguinal canal. Evidence: TAS. Frequency: Occasional (HP:0040283). (ORPHA:166035)
- Cryptorchidism (HP:0000028): Testis in inguinal canal. That is, absence of one or both testes from the scrotum owing to failure of the testis or testes to descend through the inguinal canal to the scrotum. Evidence: TAS. Frequency: Occasional (HP:0040283). (ORPHA:166035)
- Horseshoe kidney (HP:0000085): A connection of the right and left kidney by an isthmus of functioning renal parenchyma or fibrous tissue that crosses the midline. Evidence: TAS. Frequency: Occasional (HP:0040283). (ORPHA:166035)
- Renal cyst (HP:0000107): A fluid filled sac in the kidney. Evidence: TAS. Frequency: Occasional (HP:0040283). (ORPHA:166035)
- Micrognathia (HP:0000347): Developmental hypoplasia of the mandible. Evidence: TAS. Frequency: Occasional (HP:0040283). (ORPHA:166035)
- Low-set ears (HP:0000369): Upper insertion of the ear to the scalp below an imaginary horizontal line drawn between the inner canthi of the eye and extending posteriorly to the ear. Evidence: TAS. Frequency: Occasional (HP:0040283). (ORPHA:166035)
- Macrotia (HP:0000400): Median longitudinal ear length greater than two standard deviations above the mean and median ear width greater than two standard deviations above the mean (objective); or, apparent increase in length and width of the pinna (subjective). Evidence: TAS. Frequency: Occasional (HP:0040283). (ORPHA:166035)
- Underdeveloped nasal alae (HP:0000430): Thinned, deficient, or excessively arched ala nasi. Evidence: TAS. Frequency: Occasional (HP:0040283). (ORPHA:166035)
- Downslanted palpebral fissures (HP:0000494): The palpebral fissure inclination is more than two standard deviations below the mean. Evidence: TAS. Frequency: Occasional (HP:0040283). (ORPHA:166035)
- Abnormal electroretinogram (HP:0000512): Any abnormality of the electrical responses of various cell types in the retina as measured by electroretinography. Evidence: TAS. Frequency: Occasional (HP:0040283). (ORPHA:166035)
- Absent eyelashes (HP:0000561): Lack of eyelashes. Evidence: TAS. Frequency: Occasional (HP:0040283). (ORPHA:166035)
- Abnormality of the endocrine system (HP:0000818): An abnormality of the endocrine system. Evidence: TAS. Frequency: Occasional (HP:0040283). (ORPHA:166035)
- Cafe-au-lait spot (HP:0000957): Cafe-au-lait spots are hyperpigmented lesions that can vary in color from light brown to dark brown with smooth borders and having a size of 1.5 cm or more in adults and 0.5 cm or more in children. Evidence: TAS. Frequency: Occasional (HP:0040283). (ORPHA:166035)
- Visual field defect (HP:0001123). Evidence: TAS. Frequency: Occasional (HP:0040283). (ORPHA:166035)
- Neonatal hypotonia (HP:0001319): Muscular hypotonia (abnormally low muscle tone) manifesting in the neonatal period. Evidence: TAS. Frequency: Occasional (HP:0040283). (ORPHA:166035)
- Craniosynostosis (HP:0001363): Craniosynostosis refers to the premature closure of the cranial sutures. Primary craniosynostosis refers to the closure of one or more sutures due to abnormalities in skull development, and secondary craniosynostosis results from failure of brain growth. Evidence: TAS. Frequency: Occasional (HP:0040283). (ORPHA:166035)
- Intrauterine growth retardation (HP:0001511): An abnormal restriction of fetal growth with fetal weight below the tenth percentile for gestational age. Evidence: TAS. Frequency: Occasional (HP:0040283). (ORPHA:166035)
- Alopecia (HP:0001596): A noncongenital process of hair loss, which may progress to partial or complete baldness. Evidence: TAS. Frequency: Occasional (HP:0040283). (ORPHA:166035)
- Ventricular septal defect (HP:0001629): A hole between the two bottom chambers (ventricles) of the heart. The defect is centered around the most superior aspect of the ventricular septum. Evidence: TAS. Frequency: Occasional (HP:0040283). (ORPHA:166035)
- Pes planus (HP:0001763): A foot where the longitudinal arch of the foot is in contact with the ground or floor when the individual is standing; or, in a patient lying supine, a foot where the arch is in contact with the surface of a flat board pressed against the sole of the foot by the examiner with a pressure similar to that expected from weight bearing; or, the height of the arch is reduced. Evidence: TAS. Frequency: Occasional (HP:0040283). (ORPHA:166035)
- Small nail (HP:0001792): A nail that is diminished in length and width, i.e., underdeveloped nail. Evidence: TAS. Frequency: Occasional (HP:0040283). (ORPHA:166035)
- Hallux valgus (HP:0001822): Lateral deviation of the great toe (i.e., in the direction of the little toe). Evidence: TAS. Frequency: Occasional (HP:0040283). (ORPHA:166035)
- Frontal bossing (HP:0002007): Bilateral bulging of the lateral frontal bone prominences with relative sparing of the midline. Evidence: TAS. Frequency: Occasional (HP:0040283). (ORPHA:166035)
- Cerebral cortical atrophy (HP:0002120): Atrophy of the cortex of the cerebrum. Evidence: TAS. Frequency: Occasional (HP:0040283). (ORPHA:166035)
- Delayed gross motor development (HP:0002194): A type of motor delay characterized by a delay in acquiring the ability to control the large muscles of the body for walking, running, sitting, and crawling. Evidence: TAS. Frequency: Occasional (HP:0040283). (ORPHA:166035)
- Absent eyebrow (HP:0002223): Absence of the eyebrow. Evidence: TAS. Frequency: Occasional (HP:0040283). (ORPHA:166035)
- Moderate intellectual disability (HP:0002342): Moderate intellectual disability (ID) is defined as a type of ID characterized by moderately sub-average adaptive functioning and intellectual functioning, with an intelligence quotient (IQ) the range of 35-49. Evidence: TAS. Frequency: Occasional (HP:0040283). (ORPHA:166035)
- Abnormal vena cava morphology (HP:0005345): An abnormality of the structure of the veins that return deoxygenated blood from the body into the heart, i.e., the superior vena cava and the inferior vena cava. Evidence: TAS. Frequency: Occasional (HP:0040283). (ORPHA:166035)
- Metaphyseal chondrodysplasia (HP:0005871): An abnormality of skeletal development characterized by a disturbance of the metaphysis and its histological structure with relatively normal epiphyses and vertebrae. Evidence: TAS. Frequency: Occasional (HP:0040283). (ORPHA:166035)
- Chiari type I malformation (HP:0007099): Arnold-Chiari type I malformation refers to a relatively mild degree of herniation of the posteroinferior region of the cerebellum (the cerebellar tonsils) into the cervical canal with little or no displacement of the fourth ventricle. It is characterized by one or both pointed (not rounded) cerebellar tonsils that project 5 mm below the foramen magnum, measured by a line drawn from the basion to the opisthion (McRae Line). Evidence: TAS. Frequency: Occasional (HP:0040283). (ORPHA:166035)
- Ichthyosis (HP:0008064): An abnormality of the skin characterized the presence of excessive amounts of dry surface scales on the skin resulting from an abnormality of keratinization. Evidence: TAS. Frequency: Occasional (HP:0040283). (ORPHA:166035)
- Short metacarpal (HP:0010049): Diminished length of one or more metacarpal bones in relation to the others of the same hand or to the contralateral metacarpal. Evidence: TAS. Frequency: Occasional (HP:0040283). (ORPHA:166035)
- Broad columella (HP:0010761): Increased width of the columella. Evidence: TAS. Frequency: Occasional (HP:0040283). (ORPHA:166035)
- Heart murmur (HP:0030148): An extra or unusual sound heard during a heartbeat caused vibrations resulting from the flow of blood through the heart. Evidence: TAS. Frequency: Occasional (HP:0040283). (ORPHA:166035)
- Abnormality of pattern visual evoked potentials (HP:0030455). Evidence: TAS. Frequency: Occasional (HP:0040283). (ORPHA:166035)